- Progressive (HP:0003676): Applies to a disease manifestation that increases in scope or severity over the course of time, i.e., that worsens with age. Evidence: TAS. (OMIM:616410)
- Cerebellar atrophy (HP:0001272): Cerebellar atrophy is defined as a cerebellum with initially normal structures, in a posterior fossa with normal size, which displays enlarged fissures (interfolial spaces) in comparison to the foliae secondary to loss of tissue. Cerebellar atrophy implies irreversible loss of tissue and result from an ongoing progressive disease until a final stage is reached or a single injury, e.g. an intoxication or infectious event. Evidence: TAS. (OMIM:616410)
- Gait ataxia (HP:0002066): A type of ataxia characterized by the impairment of the ability to coordinate the movements required for normal walking. Gait ataxia is characteirzed by a wide-based staggering gait with a tendency to fall. Evidence: PCS. Frequency: 1/1. (PMID:25477146)
- Adult onset (HP:0003581): Onset of disease manifestations in adulthood, defined here as at the age of 16 years or later. Evidence: PCS. Frequency: 1/1. (PMID:25477146)
- Ataxia (HP:0001251): Ataxia refers to impaired coordination of voluntary muscle movement. Cerebellar ataxia refers to ataxia due to dysfunction of the cerebellum. This causes a variety of elementary neurological deficits including asynergy (lack of coordination between muscles, limbs and joints), dysmetria (lack of ability to judge distances that can lead to under- or overshoot in grasping movements), and dysdiadochokinesia (inability to perform rapid movements requiring antagonizing muscle groups to be switched on and off repeatedly). Evidence: IEA. (OMIM:616410)
- Postural instability (HP:0002172): A tendency to fall or the inability to keep oneself from falling; imbalance. The retropulsion test is widely regarded as the gold standard to evaluate postural instability, Use of the retropulsion test includes a rapid balance perturbation in the backward direction, and the number of balance correcting steps (or total absence thereof) is used to rate the degree of postural instability. Healthy subjects correct such perturbations with either one or two large steps, or without taking any steps, hinging rapidly at the hips while swinging the arms forward as a counterweight. In patients with balance impairment, balance correcting steps are often too small, forcing patients to take more than two steps. Taking three or more steps is generally considered to be abnormal, and taking more than five steps is regarded as being clearly abnormal. Markedly affected patients continue to step backward without ever regaining their balance and must be caught by the examiner (this would be called true retropulsion). Even more severely affected patients fail to correct entirely, and fall backward like a pushed toy soldier, without taking any corrective steps. Evidence: PCS. Frequency: 1/1. (PMID:25477146)
- Unsteady gait (HP:0002317). Evidence: PCS. Frequency: 1/1. (PMID:25477146)
- Autosomal dominant inheritance (HP:0000006): A mode of inheritance that is observed for traits related to a gene encoded on one of the autosomes (i.e., the human chromosomes 1-22) in which a trait manifests in heterozygotes. In the context of medical genetics, an autosomal dominant disorder is caused when a single copy of the mutant allele is present. Males and females are affected equally, and can both transmit the disorder with a risk of 50% for each child of inheriting the mutant allele. Evidence: PCS. (PMID:25477146)
- Cerebellar vermis atrophy (HP:0006855): Wasting (atrophy) of the vermis of cerebellum. Evidence: PCS. Frequency: 1/1. Onset: Adult onset (HP:0003581). (PMID:25477146)
These phenotypes are associated with the disease spinocerebellar ataxia type 41 (OMIM:616410).